Phenotypes associated with the disease dystelephalangy (OMIM:128000):
- Curved distal phalanx of the 5th finger (HP:0004226): Curved appearance of the distal phalanx of the 5th (little) finger. Evidence: TAS. (OMIM:128000)
- Autosomal dominant inheritance (HP:0000006): A mode of inheritance that is observed for traits related to a gene encoded on one of the autosomes (i.e., the human chromosomes 1-22) in which a trait manifests in heterozygotes. In the context of medical genetics, an autosomal dominant disorder is caused when a single copy of the mutant allele is present. Males and females are affected equally, and can both transmit the disorder with a risk of 50% for each child of inheriting the mutant allele. Evidence: IEA. (OMIM:128000)